- Abnormal circulating enzyme concentration or activity (HP:0012379): Concentration or activity of an enzyme is above or below the limits of normal in the blood circulation. Evidence: TAS. Frequency: Very frequent (HP:0040281). (ORPHA:103909)
- Vomiting (HP:0002013): Forceful ejection of the contents of the stomach through the mouth by means of a series of involuntary spasmic contractions. Evidence: TAS. Frequency: Occasional (HP:0040283). (ORPHA:103909)
- Diarrhea (HP:0002014): Abnormally increased frequency (usually defined as three or more) loose or watery bowel movements a day. Evidence: TAS. Frequency: Occasional (HP:0040283). (ORPHA:103909)
- Malabsorption (HP:0002024): Impaired ability to absorb one or more nutrients from the intestine. Evidence: TAS. Frequency: Occasional (HP:0040283). (ORPHA:103909)
- Abdominal pain (HP:0002027): An unpleasant sensation characterized by physical discomfort (such as pricking, throbbing, or aching) and perceived to originate in the abdomen. Evidence: TAS. Frequency: Occasional (HP:0040283). (ORPHA:103909)
- Abdominal distention (HP:0003270): Distention of the abdomen. Evidence: TAS. Frequency: Occasional (HP:0040283). (ORPHA:103909)
These phenotypes are associated with the disease Trehalase deficiency (ORPHA:103909).